Phenotypes associated with the disease autosomal recessive nonsyndromic hearing loss 39 (OMIM:608265):
- Autosomal recessive inheritance (HP:0000007): A mode of inheritance that is observed for traits related to a gene encoded on one of the autosomes (i.e., the human chromosomes 1-22) in which a trait manifests in individuals with two pathogenic alleles, either homozygotes (two copies of the same mutant allele) or compound heterozygotes (whereby each copy of a gene has a distinct mutant allele). Evidence: TAS. (OMIM:608265)
- Prelingual sensorineural hearing impairment (HP:0000399): A form of sensorineural deafness with either congenital onset or infantile onset, i.e., before the acquisition of speech. Evidence: TAS. (OMIM:608265)